- Abnormality of blood and blood-forming tissues (HP:0001871): An abnormality of the hematopoietic system. Evidence: IEA. (OMIM:151500)
- Autosomal dominant inheritance (HP:0000006): A mode of inheritance that is observed for traits related to a gene encoded on one of the autosomes (i.e., the human chromosomes 1-22) in which a trait manifests in heterozygotes. In the context of medical genetics, an autosomal dominant disorder is caused when a single copy of the mutant allele is present. Males and females are affected equally, and can both transmit the disorder with a risk of 50% for each child of inheriting the mutant allele. Evidence: IEA. (OMIM:151500)
These phenotypes are associated with the disease leukocyte nuclear appendages, hereditary prevalence of (OMIM:151500).